- Palmoplantar hyperhidrosis (HP:0007410): An abnormally increased perspiration on palms and soles. Evidence: IEA. (OMIM:144110)
- Autosomal dominant inheritance (HP:0000006): A mode of inheritance that is observed for traits related to a gene encoded on one of the autosomes (i.e., the human chromosomes 1-22) in which a trait manifests in heterozygotes. In the context of medical genetics, an autosomal dominant disorder is caused when a single copy of the mutant allele is present. Males and females are affected equally, and can both transmit the disorder with a risk of 50% for each child of inheriting the mutant allele. Evidence: IEA. (OMIM:144110)
These phenotypes are associated with the disease hyperhidrosis palmaris ET plantaris (OMIM:144110).